- Osteoporosis (HP:0000939): Osteoporosis is a systemic skeletal disease characterized by low bone density and microarchitectural deterioration of bone tissue with a consequent increase in bone fragility. According to the WHO criteria, osteoporosis is defined as a BMD that lies 2.5 standard deviations or more below the average value for young healthy adults (a T-score below -2.5 SD). Evidence: IEA. (OMIM:166710)
- Autosomal dominant inheritance (HP:0000006): A mode of inheritance that is observed for traits related to a gene encoded on one of the autosomes (i.e., the human chromosomes 1-22) in which a trait manifests in heterozygotes. In the context of medical genetics, an autosomal dominant disorder is caused when a single copy of the mutant allele is present. Males and females are affected equally, and can both transmit the disorder with a risk of 50% for each child of inheriting the mutant allele. Evidence: IEA. (OMIM:166710)
These phenotypes are associated with the disease osteoporosis (OMIM:166710).